- Scarring alopecia of scalp (HP:0004552). Evidence: TAS. (OMIM:618352)
- Autosomal dominant inheritance (HP:0000006): A mode of inheritance that is observed for traits related to a gene encoded on one of the autosomes (i.e., the human chromosomes 1-22) in which a trait manifests in heterozygotes. In the context of medical genetics, an autosomal dominant disorder is caused when a single copy of the mutant allele is present. Males and females are affected equally, and can both transmit the disorder with a risk of 50% for each child of inheriting the mutant allele. Evidence: IEA. (OMIM:618352)
These phenotypes are associated with the disease central centrifugal cicatricial alopecia (OMIM:618352).